- Thin upper lip vermilion (HP:0000219): Height of the vermilion of the upper lip in the midline more than 2 SD below the mean. Alternatively, an apparently reduced height of the vermilion of the upper lip in the frontal view (subjective). Evidence: TAS. Frequency: Frequent (HP:0040282). (ORPHA:357175)
- Everted lower lip vermilion (HP:0000232): An abnormal configuration of the lower lip such that it is turned outward i.e., everted, with the Inner aspect of the lower lip vermilion (normally opposing the teeth) being visible in a frontal view. Evidence: TAS. Frequency: Frequent (HP:0040282). (ORPHA:357175)
- Malar flattening (HP:0000272): Underdevelopment of the malar prominence of the jugal bone (zygomatic bone in mammals), appreciated in profile, frontal view, and/or by palpation. Evidence: TAS. Frequency: Frequent (HP:0040282). (ORPHA:357175)
- Hypertelorism (HP:0000316): Interpupillary distance more than 2 SD above the mean (alternatively, the appearance of an increased interpupillary distance or widely spaced eyes). Evidence: TAS. Frequency: Frequent (HP:0040282). (ORPHA:357175)
- Long philtrum (HP:0000343): Distance between nasal base and midline upper lip vermilion border more than 2 SD above the mean. Alternatively, an apparently increased distance between nasal base and midline upper lip vermilion border. Evidence: TAS. Frequency: Frequent (HP:0040282). (ORPHA:357175)
- Micrognathia (HP:0000347): Developmental hypoplasia of the mandible. Evidence: TAS. Frequency: Frequent (HP:0040282). (ORPHA:357175)
- Low-set ears (HP:0000369): Upper insertion of the ear to the scalp below an imaginary horizontal line drawn between the inner canthi of the eye and extending posteriorly to the ear. Evidence: TAS. Frequency: Frequent (HP:0040282). (ORPHA:357175)
- Wide nose (HP:0000445): Interalar distance more than two standard deviations above the mean for age, i.e., an apparently increased width of the nasal base and alae. Evidence: TAS. Frequency: Frequent (HP:0040282). (ORPHA:357175)
- Synophrys (HP:0000664): Meeting of the medial eyebrows in the midline. Evidence: TAS. Frequency: Frequent (HP:0040282). (ORPHA:357175)
- Abnormality of the skeletal system (HP:0000924): An abnormality of the skeletal system. Evidence: TAS. Frequency: Frequent (HP:0040282). (ORPHA:357175)
- Hirsutism (HP:0001007): Abnormally increased hair growth referring to a male pattern of body hair (androgenic hair). Evidence: TAS. Frequency: Frequent (HP:0040282). (ORPHA:357175)
- Hypotonia (HP:0001252): Hypotonia is an abnormally low muscle tone (the amount of tension or resistance to movement in a muscle). Even when relaxed, muscles have a continuous and passive partial contraction which provides some resistance to passive stretching. Hypotonia thus manifests as diminished resistance to passive stretching. Hypotonia is not the same as muscle weakness, although the two conditions can co-exist. Evidence: TAS. Frequency: Frequent (HP:0040282). (ORPHA:357175)
- Mild intellectual disability (HP:0001256): Mild intellectual disability (ID) is defined as a type of ID characterized by mildly sub-average adaptive functioning and intellectual functioning, with an intelligence quotient (IQ) the range of 50-69. Evidence: TAS. Frequency: Frequent (HP:0040282). (ORPHA:357175)
- Global developmental delay (HP:0001263): A delay in the achievement of motor or mental milestones in the domains of development of a child, including motor skills, speech and language, cognitive skills, and social and emotional skills. This term should only be used to describe children younger than five years of age. Evidence: TAS. Frequency: Frequent (HP:0040282). (ORPHA:357175)
- Abnormal facial shape (HP:0001999): An abnormal morphology (form) of the face or its components. Evidence: TAS. Frequency: Frequent (HP:0040282). (ORPHA:357175)
- Hypoplasia of the ulna (HP:0003022): Underdevelopment of the ulna. Evidence: TAS. Frequency: Frequent (HP:0040282). (ORPHA:357175)
- Decreased body weight (HP:0004325): Abnormally low body weight. Evidence: TAS. Frequency: Frequent (HP:0040282). (ORPHA:357175)
- Flat occiput (HP:0005469): Reduced convexity of the occiput (posterior part of skull). Evidence: TAS. Frequency: Frequent (HP:0040282). (ORPHA:357175)
- Microtia (HP:0008551): Underdevelopment of the external ear. Evidence: TAS. Frequency: Frequent (HP:0040282). (ORPHA:357175)
- Thick nasal alae (HP:0009928): Increase in bulk of the ala nasi. Evidence: TAS. Frequency: Frequent (HP:0040282). (ORPHA:357175)
- Clinodactyly (HP:0030084): An angulation of a digit at an interphalangeal joint in the plane of the palm (finger) or sole (toe). Evidence: TAS. Frequency: Frequent (HP:0040282). (ORPHA:357175)
- Broad forehead (HP:0000337): Width of the forehead or distance between the frontotemporales is more than two standard deviations above the mean (objective); or apparently increased distance between the two sides of the forehead. Evidence: TAS. Frequency: Occasional (HP:0040283). (ORPHA:357175)
- Downslanted palpebral fissures (HP:0000494): The palpebral fissure inclination is more than two standard deviations below the mean. Evidence: TAS. Frequency: Occasional (HP:0040283). (ORPHA:357175)
- Moderate intellectual disability (HP:0002342): Moderate intellectual disability (ID) is defined as a type of ID characterized by moderately sub-average adaptive functioning and intellectual functioning, with an intelligence quotient (IQ) the range of 35-49. Evidence: TAS. Frequency: Occasional (HP:0040283). (ORPHA:357175)
- Severe intellectual disability (HP:0010864): Severe intellectual disability (ID) is defined as a type of ID characterized by severely sub-average adaptive functioning and intellectual functioning, with an intelligence quotient (IQ) the range of 20-34. Evidence: TAS. Frequency: Occasional (HP:0040283). (ORPHA:357175)
These phenotypes are associated with the disease Short ulna-dysmorphism-hypotonia-intellectual disability syndrome (ORPHA:357175).